Phenotypes associated with the disease Microcephaly-polymicrogyria-corpus callosum agenesis syndrome (ORPHA:171703):
- Agenesis of corpus callosum (HP:0001274): Absence of the corpus callosum as a result of the failure of the corpus callosum to develop, which can be the result of a failure in any one of the multiple steps of callosal development including cellular proliferation and migration, axonal growth or glial patterning at the midline. Evidence: TAS. Frequency: Frequent (HP:0040282). (ORPHA:171703)
- Cerebellar hypoplasia (HP:0001321): Cerebellar hypoplasia is a descriptive term implying a cerebellum with a reduced volume, but a normal shape and is stable over time. Evidence: TAS. Frequency: Frequent (HP:0040282). (ORPHA:171703)
- Respiratory distress (HP:0002098): Respiratory distress is objectively observable as the physical or emotional consequences from the experience of dyspnea. The physical presentation of respiratory distress is generally referred to as labored breathing, while the sensation of respiratory distress is called shortness of breath or dyspnea. Evidence: TAS. Frequency: Frequent (HP:0040282). (ORPHA:171703)
- Ventriculomegaly (HP:0002119): An increase in size of the ventricular system of the brain. Evidence: TAS. Frequency: Frequent (HP:0040282). (ORPHA:171703)
- Polymicrogyria (HP:0002126): Polymicrogyria is a congenital malformation of the cerebral cortex characterized by abnormal cortical layering (lamination) and an excessive number of small gyri (folds). Evidence: TAS. Frequency: Frequent (HP:0040282). (ORPHA:171703)
- Recurrent infections (HP:0002719): Increased susceptibility to infections as manifested by repeated bouts of infection. Evidence: TAS. Frequency: Frequent (HP:0040282). (ORPHA:171703)
- Primary microcephaly (HP:0011451): Head circumference below 2 standard deviations below the mean for age and gender at birth. Evidence: TAS. Frequency: Frequent (HP:0040282). (ORPHA:171703)